- Nephropathy (HP:0000112): A nonspecific term referring to disease or damage of the kidneys. Evidence: TAS. Frequency: Very frequent (HP:0040281). (ORPHA:220497)
- Oculomotor apraxia (HP:0000657): Ocular motor apraxia is a deficiency in voluntary, horizontal, lateral, fast eye movements (saccades) with retention of slow pursuit movements. The inability to follow objects visually is often compensated by head movements. There may be decreased smooth pursuit, and cancelation of the vestibulo-ocular reflex. Evidence: TAS. Frequency: Very frequent (HP:0040281). (ORPHA:220497)
- Intellectual disability (HP:0001249): The term intellectual disability or intellectual developmental disorder is used to describe significantly sub-average intellectual and adaptive functioning based on clinical assessment and as measured by individually administered, appropriately normed, standardized and validated tests of intellectual functioning and adaptive behavior, with onset during the developmental period from infancy through adolescence. Evidence: TAS. Frequency: Very frequent (HP:0040281). (ORPHA:220497)
- Ataxia (HP:0001251): Ataxia refers to impaired coordination of voluntary muscle movement. Cerebellar ataxia refers to ataxia due to dysfunction of the cerebellum. This causes a variety of elementary neurological deficits including asynergy (lack of coordination between muscles, limbs and joints), dysmetria (lack of ability to judge distances that can lead to under- or overshoot in grasping movements), and dysdiadochokinesia (inability to perform rapid movements requiring antagonizing muscle groups to be switched on and off repeatedly). Evidence: TAS. Frequency: Very frequent (HP:0040281). (ORPHA:220497)
- Hypotonia (HP:0001252): Hypotonia is an abnormally low muscle tone (the amount of tension or resistance to movement in a muscle). Even when relaxed, muscles have a continuous and passive partial contraction which provides some resistance to passive stretching. Hypotonia thus manifests as diminished resistance to passive stretching. Hypotonia is not the same as muscle weakness, although the two conditions can co-exist. Evidence: TAS. Frequency: Very frequent (HP:0040281). (ORPHA:220497)
- Global developmental delay (HP:0001263): A delay in the achievement of motor or mental milestones in the domains of development of a child, including motor skills, speech and language, cognitive skills, and social and emotional skills. This term should only be used to describe children younger than five years of age. Evidence: TAS. Frequency: Very frequent (HP:0040281). (ORPHA:220497)
- Cerebellar vermis hypoplasia (HP:0001320): Underdevelopment of the vermis of cerebellum. Evidence: TAS. Frequency: Very frequent (HP:0040281). (ORPHA:220497)
- Apnea (HP:0002104): Lack of breathing with no movement of the respiratory muscles and no exchange of air in the lungs. This term refers to a disposition to have recurrent episodes of apnea rather than to a single event. Evidence: TAS. Frequency: Very frequent (HP:0040281). (ORPHA:220497)
- Molar tooth sign on MRI (HP:0002419): An abnormal appearance of the midbrain in axial magnetic resonance imaging in which the elongated superior cerebellar peduncles give the midbrain an appearance reminiscent of a molar or wisdom tooth. Evidence: TAS. Frequency: Very frequent (HP:0040281). (ORPHA:220497)
- Abnormal pattern of respiration (HP:0002793): An anomaly of the rhythm or depth of breathing. Evidence: TAS. Frequency: Very frequent (HP:0040281). (ORPHA:220497)
- Long face (HP:0000276): Facial height (length) is more than 2 standard deviations above the mean (objective); or, an apparent increase in the height (length) of the face (subjective). Evidence: TAS. Frequency: Frequent (HP:0040282). (ORPHA:220497)
- Posteriorly rotated ears (HP:0000358): A type of abnormal location of the ears in which the position of the ears is characterized by posterior rotation (the superior part of the ears is rotated towards the back of the head, and the inferior part of the ears towards the front). Evidence: TAS. Frequency: Frequent (HP:0040282). (ORPHA:220497)
- Nystagmus (HP:0000639): Rhythmic, involuntary oscillations of one or both eyes related to abnormality in fixation, conjugate gaze, or vestibular mechanisms. Evidence: TAS. Frequency: Frequent (HP:0040282). (ORPHA:220497)
- Gait disturbance (HP:0001288): The term gait disturbance can refer to any disruption of the ability to walk. Evidence: TAS. Frequency: Frequent (HP:0040282). (ORPHA:220497)
- Biparietal narrowing (HP:0004422): A narrowing of the biparietal diameter (i.e., of the transverse distance between the protuberances of the two parietal bones of the skull). Evidence: TAS. Frequency: Frequent (HP:0040282). (ORPHA:220497)
- Feeding difficulties (HP:0011968): Impaired ability to eat related to problems gathering food and getting ready to suck, chew, or swallow it. Evidence: TAS. Frequency: Frequent (HP:0040282). (ORPHA:220497)
- Renal insufficiency (HP:0000083): A reduction in the level of performance of the kidneys in areas of function comprising the concentration of urine, removal of wastes, the maintenance of electrolyte balance, homeostasis of blood pressure, and calcium metabolism. Evidence: TAS. Frequency: Occasional (HP:0040283). (ORPHA:220497)
- Cleft palate (HP:0000175): Cleft palate is a developmental defect of the palate resulting from a failure of fusion of the palatine processes and manifesting as a separation of the roof of the mouth (soft and hard palate). Evidence: TAS. Frequency: Occasional (HP:0040283). (ORPHA:220497)
- Orofacial cleft (HP:0000202): The presence of a cleft (gap, opening, or groove) in the oral cavity, including cleft of the upper lip and/or cleft of the palate. Cleft of the upper lip is visible as a groove or fissure in the lip, most frequently due to a congenital failure of the maxillary and median nasal processes to fuse. Cleft palate is characterized by a grooved depression or fissure in the roof of the mouth, most often resulting from a congenital failure of the palate to fuse properly. Clefts of the lip and palate can occur individually or together. It is preferable to code each defect separately. Evidence: TAS. Frequency: Occasional (HP:0040283). (ORPHA:220497)
- Hydrocephalus (HP:0000238): Hydrocephalus is an active distension of the ventricular system of the brain resulting from inadequate passage of CSF from its point of production within the cerebral ventricles to its point of absorption into the systemic circulation. Evidence: TAS. Frequency: Occasional (HP:0040283). (ORPHA:220497)
- Prominent nasal bridge (HP:0000426): Anterior positioning of the nasal root in comparison to the usual positioning for age. Evidence: TAS. Frequency: Occasional (HP:0040283). (ORPHA:220497)
- Anteverted nares (HP:0000463): Anteriorly-facing nostrils viewed with the head in the Frankfurt horizontal and the eyes of the observer level with the eyes of the subject. This gives the appearance of an upturned nose (upturned nasal tip). Evidence: TAS. Frequency: Occasional (HP:0040283). (ORPHA:220497)
- Strabismus (HP:0000486): A misalignment of the eyes so that the visual axes deviate from bifoveal fixation. The classification of strabismus may be based on a number of features including the relative position of the eyes, whether the deviation is latent or manifest, intermittent or constant, concomitant or otherwise and according to the age of onset and the relevance of any associated refractive error. Evidence: TAS. Frequency: Occasional (HP:0040283). (ORPHA:220497)
- Ptosis (HP:0000508): The upper eyelid margin is positioned 3 mm or more lower than usual and covers the superior portion of the iris (objective); or, the upper lid margin obscures at least part of the pupil (subjective). Evidence: TAS. Frequency: Occasional (HP:0040283). (ORPHA:220497)
- Iris coloboma (HP:0000612): A coloboma of the iris. Evidence: TAS. Frequency: Occasional (HP:0040283). (ORPHA:220497)
- Abnormality of the hypothalamus-pituitary axis (HP:0000864): Abnormality of the pituitary gland (also known as hypophysis), which is an endocrine gland that protrudes from the bottom of the hypothalamus at the base of the brain. The pituitary gland secretes the hormones ACTH, TSH, PRL, GH, endorphins, FSH, LH, oxytocin, and antidiuretic hormone. The secretion of hormones from the anterior pituitary is under the strict control of hypothalamic hormones, and the posterior pituitary is essentially an extension of the hypothalamus, so that hypothalamus and pituitary gland may be regarded as a functional unit. Evidence: TAS. Frequency: Occasional (HP:0040283). (ORPHA:220497)
- Hand polydactyly (HP:0001161): A kind of polydactyly characterized by the presence of a supernumerary finger or fingers. Evidence: TAS. Frequency: Occasional (HP:0040283). (ORPHA:220497)
- Seizure (HP:0001250): A seizure is an intermittent abnormality of nervous system physiology characterized by a transient occurrence of signs and/or symptoms due to abnormal excessive or synchronous neuronal activity in the brain. Evidence: TAS. Frequency: Occasional (HP:0040283). (ORPHA:220497)
- Agenesis of corpus callosum (HP:0001274): Absence of the corpus callosum as a result of the failure of the corpus callosum to develop, which can be the result of a failure in any one of the multiple steps of callosal development including cellular proliferation and migration, axonal growth or glial patterning at the midline. Evidence: TAS. Frequency: Occasional (HP:0040283). (ORPHA:220497)
- Tremor (HP:0001337): An unintentional, oscillating to-and-fro muscle movement about a joint axis. Evidence: TAS. Frequency: Occasional (HP:0040283). (ORPHA:220497)
- Encephalocele (HP:0002084): A neural tube defect characterized by sac-like protrusions of the brain and the membranes that cover it through openings in the skull. Evidence: TAS. Frequency: Occasional (HP:0040283). (ORPHA:220497)
- Polymicrogyria (HP:0002126): Polymicrogyria is a congenital malformation of the cerebral cortex characterized by abnormal cortical layering (lamination) and an excessive number of small gyri (folds). Evidence: TAS. Frequency: Occasional (HP:0040283). (ORPHA:220497)
- Aganglionic megacolon (HP:0002251): An abnormality resulting from a lack of intestinal ganglion cells (i.e., an aganglionic section of bowel) that results in bowel obstruction with enlargement of the colon. Evidence: TAS. Frequency: Occasional (HP:0040283). (ORPHA:220497)
- Highly arched eyebrow (HP:0002553): Increased height of the central portion of the eyebrow, forming a crescent, semicircular, or inverted U shape. Evidence: TAS. Frequency: Occasional (HP:0040283). (ORPHA:220497)
- Scoliosis (HP:0002650): The presence of an abnormal lateral curvature of the spine. Evidence: TAS. Frequency: Occasional (HP:0040283). (ORPHA:220497)
- Abnormal cardiovascular system morphology (HP:0030680): Any structural anomaly of the heart and blood vessels. Evidence: TAS. Frequency: Occasional (HP:0040283). (ORPHA:220497)
These phenotypes are associated with the disease Joubert syndrome with renal defect (ORPHA:220497).